- Macrocephaly (HP:0000256): Occipitofrontal (head) circumference greater than 97th centile compared to appropriate, age matched, sex-matched normal standards. Alternatively, a apparently increased size of the cranium. Evidence: TAS. Frequency: Very frequent (HP:0040281). (ORPHA:457279)
- Delayed speech and language development (HP:0000750): A degree of language development that is significantly below the norm for a child of a specified age. Evidence: TAS. Frequency: Very frequent (HP:0040281). (ORPHA:457279)
- Global developmental delay (HP:0001263): A delay in the achievement of motor or mental milestones in the domains of development of a child, including motor skills, speech and language, cognitive skills, and social and emotional skills. This term should only be used to describe children younger than five years of age. Evidence: TAS. Frequency: Very frequent (HP:0040281). (ORPHA:457279)
- Generalized hypotonia (HP:0001290): Generalized muscular hypotonia (abnormally low muscle tone). Evidence: TAS. Frequency: Very frequent (HP:0040281). (ORPHA:457279)
- Neonatal hypotonia (HP:0001319): Muscular hypotonia (abnormally low muscle tone) manifesting in the neonatal period. Evidence: TAS. Frequency: Very frequent (HP:0040281). (ORPHA:457279)
- Delayed ability to walk (HP:0031936): A failure to achieve the ability to walk at an appropriate developmental stage. Most children learn to walk in a series of stages, and learn to walk short distances independently between 12 and 15 months. Evidence: TAS. Frequency: Very frequent (HP:0040281). (ORPHA:457279)
- Abnormality of the eye (HP:0000478): Any abnormality of the eye, including location, spacing, and intraocular abnormalities. Evidence: TAS. Frequency: Frequent (HP:0040282). (ORPHA:457279)
- Aggressive behavior (HP:0000718): Behavior or an act aimed at harming a person, animal, or physical property (e.g., acts of physical violence; shouting, swearing, and using harsh language; slashing someone's tires). Evidence: TAS. Frequency: Frequent (HP:0040282). (ORPHA:457279)
- Autistic behavior (HP:0000729): Persistent deficits in social interaction and communication and interaction as well as a markedly restricted repertoire of activity and interest as well as repetitive patterns of behavior. Evidence: TAS. Frequency: Frequent (HP:0040282). (ORPHA:457279)
- Motor stereotypy (HP:0000733): Use of the same abnormal action in response to certain triggers or at random. They may be used as a way to regulate one's internal state but must otherwise have no apparent functional purpose. Evidence: TAS. Frequency: Frequent (HP:0040282). (ORPHA:457279)
- Low frustration tolerance (HP:0000744): The feeling of frustration can be defined as an emotional reaction that occurs when a desired goal is not achieved. Frustration intolerance is defined as an age-inappropriate response to frustration, characterized by crying or temper tantrums in children, or aggressive or other maladaptive behaviors. Evidence: TAS. Frequency: Frequent (HP:0040282). (ORPHA:457279)
- Absent speech (HP:0001344): Complete lack of development of speech and language abilities. Evidence: TAS. Frequency: Frequent (HP:0040282). (ORPHA:457279)
- Abnormal facial shape (HP:0001999): An abnormal morphology (form) of the face or its components. Evidence: TAS. Frequency: Frequent (HP:0040282). (ORPHA:457279)
- Unsteady gait (HP:0002317). Evidence: TAS. Frequency: Frequent (HP:0040282). (ORPHA:457279)
- Moderate intellectual disability (HP:0002342): Moderate intellectual disability (ID) is defined as a type of ID characterized by moderately sub-average adaptive functioning and intellectual functioning, with an intelligence quotient (IQ) the range of 35-49. Evidence: TAS. Frequency: Frequent (HP:0040282). (ORPHA:457279)
- Poor speech (HP:0002465). Evidence: TAS. Frequency: Frequent (HP:0040282). (ORPHA:457279)
- Scoliosis (HP:0002650): The presence of an abnormal lateral curvature of the spine. Evidence: TAS. Frequency: Frequent (HP:0040282). (ORPHA:457279)
- Severe intellectual disability (HP:0010864): Severe intellectual disability (ID) is defined as a type of ID characterized by severely sub-average adaptive functioning and intellectual functioning, with an intelligence quotient (IQ) the range of 20-34. Evidence: TAS. Frequency: Frequent (HP:0040282). (ORPHA:457279)
- Abnormal temper tantrums (HP:0025160): Temper tantrums are brief episodes of extreme, unpleasant, and sometimes aggressive behaviors in response to frustration or anger, which are a normal part of development in toddlers. Temper tantrums that occur more frequently in a given time and/or are more severe in symptomatology and/or longer in duration and/or inappropriate for the given age compared to a temper tantrum that naturally occurs as a part of the developmental process are classified as abnormal temper tantrums. Evidence: TAS. Frequency: Frequent (HP:0040282). (ORPHA:457279)
- Long face (HP:0000276): Facial height (length) is more than 2 standard deviations above the mean (objective); or, an apparent increase in the height (length) of the face (subjective). Evidence: TAS. Frequency: Occasional (HP:0040283). (ORPHA:457279)
- Triangular face (HP:0000325): Facial contour, as viewed from the front, triangular in shape, with breadth at the temples and tapering to a narrow chin. Evidence: TAS. Frequency: Occasional (HP:0040283). (ORPHA:457279)
- Low-set ears (HP:0000369): Upper insertion of the ear to the scalp below an imaginary horizontal line drawn between the inner canthi of the eye and extending posteriorly to the ear. Evidence: TAS. Frequency: Occasional (HP:0040283). (ORPHA:457279)
- Strabismus (HP:0000486): A misalignment of the eyes so that the visual axes deviate from bifoveal fixation. The classification of strabismus may be based on a number of features including the relative position of the eyes, whether the deviation is latent or manifest, intermittent or constant, concomitant or otherwise and according to the age of onset and the relevance of any associated refractive error. Evidence: TAS. Frequency: Occasional (HP:0040283). (ORPHA:457279)
- Downslanted palpebral fissures (HP:0000494): The palpebral fissure inclination is more than two standard deviations below the mean. Evidence: TAS. Frequency: Occasional (HP:0040283). (ORPHA:457279)
- Ataxia (HP:0001251): Ataxia refers to impaired coordination of voluntary muscle movement. Cerebellar ataxia refers to ataxia due to dysfunction of the cerebellum. This causes a variety of elementary neurological deficits including asynergy (lack of coordination between muscles, limbs and joints), dysmetria (lack of ability to judge distances that can lead to under- or overshoot in grasping movements), and dysdiadochokinesia (inability to perform rapid movements requiring antagonizing muscle groups to be switched on and off repeatedly). Evidence: TAS. Frequency: Occasional (HP:0040283). (ORPHA:457279)
- Abnormal corpus callosum morphology (HP:0001273): Abnormality of the corpus callosum. Evidence: TAS. Frequency: Occasional (HP:0040283). (ORPHA:457279)
- Abnormal heart morphology (HP:0001627): Any structural anomaly of the heart. Evidence: TAS. Frequency: Occasional (HP:0040283). (ORPHA:457279)
- Ventricular septal defect (HP:0001629): A hole between the two bottom chambers (ventricles) of the heart. The defect is centered around the most superior aspect of the ventricular septum. Evidence: TAS. Frequency: Occasional (HP:0040283). (ORPHA:457279)
- Cavum septum pellucidum (HP:0002389): If the two laminae of the septum pellucidum are not fused then a fluid-filled space or cavum is present. The cavum septum pellucidum is present at birth but usually obliterates by the age of 3 to 6 months. It is up to 1cm in width and the walls are parallel. It is an enclosed space and is not part of the ventricular system or connected with the subarachnoid space. Evidence: TAS. Frequency: Occasional (HP:0040283). (ORPHA:457279)
- Abnormal cerebral white matter morphology (HP:0002500): An abnormality of the cerebral white matter. Evidence: TAS. Frequency: Occasional (HP:0040283). (ORPHA:457279)
- Short nose (HP:0003196): Distance from nasion to subnasale more than two standard deviations below the mean, or alternatively, an apparently decreased length from the nasal root to the nasal tip. Evidence: TAS. Frequency: Occasional (HP:0040283). (ORPHA:457279)
- Lateral ventricle dilatation (HP:0006956). Evidence: TAS. Frequency: Occasional (HP:0040283). (ORPHA:457279)
- Prominent forehead (HP:0011220): Forward prominence of the entire forehead, due to protrusion of the frontal bone. Evidence: TAS. Frequency: Occasional (HP:0040283). (ORPHA:457279)
- Midface retrusion (HP:0011800): Posterior positions and/or vertical shortening of the infraorbital and perialar regions, or increased concavity of the face and/or reduced nasolabial angle. Evidence: TAS. Frequency: Occasional (HP:0040283). (ORPHA:457279)
- Arachnoid cyst (HP:0100702): An extra-parenchymal and intra-arachnoidal collection of fluid with a composition similar to that of cerebrospinal fluid. Evidence: TAS. Frequency: Occasional (HP:0040283). (ORPHA:457279)
- Submucous cleft hard palate (HP:0000176): Hard-palate submucous clefts are characterized by bony defects in the midline of the bony palate that are covered by the mucous membrane of the roof of the mouth. It may be possible to detect a submucous cleft hard palate upon palpation as a notch in the bony palate. Evidence: TAS. Frequency: Very rare (HP:0040284). (ORPHA:457279)
- High palate (HP:0000218): Height of the palate more than 2 SD above the mean (objective) or palatal height at the level of the first permanent molar more than twice the height of the teeth (subjective). Evidence: TAS. Frequency: Very rare (HP:0040284). (ORPHA:457279)
- Thin upper lip vermilion (HP:0000219): Height of the vermilion of the upper lip in the midline more than 2 SD below the mean. Alternatively, an apparently reduced height of the vermilion of the upper lip in the frontal view (subjective). Evidence: TAS. Frequency: Very rare (HP:0040284). (ORPHA:457279)
- Wide anterior fontanel (HP:0000260): Enlargement of the anterior fontanelle with respect to age-dependent norms. Evidence: TAS. Frequency: Very rare (HP:0040284). (ORPHA:457279)
- Dolichocephaly (HP:0000268): An abnormality of skull shape characterized by a increased anterior-posterior diameter, i.e., an increased antero-posterior dimension of the skull. Cephalic index less than 76%. Alternatively, an apparently increased antero-posterior length of the head compared to width. Often due to premature closure of the sagittal suture. Evidence: TAS. Frequency: Very rare (HP:0040284). (ORPHA:457279)
- Facial asymmetry (HP:0000324): An abnormal difference between the left and right sides of the face. Evidence: TAS. Frequency: Very rare (HP:0040284). (ORPHA:457279)
- Long philtrum (HP:0000343): Distance between nasal base and midline upper lip vermilion border more than 2 SD above the mean. Alternatively, an apparently increased distance between nasal base and midline upper lip vermilion border. Evidence: TAS. Frequency: Very rare (HP:0040284). (ORPHA:457279)
- Astigmatism (HP:0000483): A type of refraction error associated with abnormal curvatures on the anterior and/or posterior surface of the cornea. Evidence: TAS. Frequency: Very rare (HP:0040284). (ORPHA:457279)
- Alternating esotropia (HP:0001137): Esotropia in which either eye may be used for fixation. Evidence: TAS. Frequency: Very rare (HP:0040284). (ORPHA:457279)
- Seizure (HP:0001250): A seizure is an intermittent abnormality of nervous system physiology characterized by a transient occurrence of signs and/or symptoms due to abnormal excessive or synchronous neuronal activity in the brain. Evidence: TAS. Frequency: Very rare (HP:0040284). (ORPHA:457279)
- Areflexia (HP:0001284): Absence of neurologic reflexes such as the knee-jerk reaction. Evidence: TAS. Frequency: Very rare (HP:0040284). (ORPHA:457279)
- Plagiocephaly (HP:0001357): Asymmetric head shape, which is usually a combination of unilateral occipital flattening with ipsilateral frontal prominence, leading to rhomboid cranial shape. Evidence: TAS. Frequency: Very rare (HP:0040284). (ORPHA:457279)
- Congenital hip dislocation (HP:0001374). Evidence: TAS. Frequency: Very rare (HP:0040284). (ORPHA:457279)
- Rotary nystagmus (HP:0001583): A form of nystagmus in which the eyeball makes rotary motions around the axis. Evidence: TAS. Frequency: Very rare (HP:0040284). (ORPHA:457279)
- Atrial septal defect (HP:0001631): Atrial septal defect (ASD) is a congenital abnormality of the interatrial septum that enables blood flow between the left and right atria via the interatrial septum. Evidence: TAS. Frequency: Very rare (HP:0040284). (ORPHA:457279)
- Bicuspid aortic valve (HP:0001647): The presence of an aortic valve with two instead of the normal three cusps (flaps). Bicuspid aortic valvue is a malformation of a commissure (small space between the attachment of each cusp to the aortic wall) and the adjacent parts of the two corresponding cusps forming a raphe (the fused area of the two underdeveloped cusps turning into a malformed commissure between both cusps; the raphe is a fibrous ridge that extends from the commissure to the free edge of the two underdeveloped, conjoint cusps). Evidence: TAS. Frequency: Very rare (HP:0040284). (ORPHA:457279)
- Patent foramen ovale (HP:0001655): Failure of the foramen ovale to seal postnatally, leaving a potential conduit between the left and right cardiac atria. Evidence: TAS. Frequency: Very rare (HP:0040284). (ORPHA:457279)
- Hypoglycemia (HP:0001943): A decreased concentration of glucose in the blood. Evidence: TAS. Frequency: Very rare (HP:0040284). (ORPHA:457279)
- Frontal bossing (HP:0002007): Bilateral bulging of the lateral frontal bone prominences with relative sparing of the midline. Evidence: TAS. Frequency: Very rare (HP:0040284). (ORPHA:457279)
- Pyloric stenosis (HP:0002021): Pyloric stenosis, also known as infantile hypertrophic pyloric stenosis, is an uncommon condition in infants characterized by abnormal thickening of the pylorus muscles in the stomach leading to gastric outlet obstruction. Clinically infants are well at birth. Then, at 3 to 6 weeks of age, the infants present with projectile vomiting, potentially leading to dehydration and weight loss. Evidence: TAS. Frequency: Very rare (HP:0040284). (ORPHA:457279)
- Chronic diarrhea (HP:0002028): The presence of chronic diarrhea, which is usually taken to mean diarrhea that has persisted for over 4 weeks. Evidence: TAS. Frequency: Very rare (HP:0040284). (ORPHA:457279)
- Supernumerary nipple (HP:0002558): Presence of more than two nipples. Evidence: TAS. Frequency: Very rare (HP:0040284). (ORPHA:457279)
- Impaired mastication (HP:0005216): An abnormal reduction in the ability to masticate (chew), i.e., in the ability to crush and ground food in preparation for swallowing. Evidence: TAS. Frequency: Very rare (HP:0040284). (ORPHA:457279)
- Congenital muscular torticollis (HP:0005988): A congenital form of torticollis resulting from shortening of the sternocleidomastoid muscle and leading to a limited range of motion in both rotation and lateral bending. Evidence: TAS. Frequency: Very rare (HP:0040284). (ORPHA:457279)
- Hypoplastic fifth toenail (HP:0011937): Underdeveloped nails of the fifth toes. Evidence: TAS. Frequency: Very rare (HP:0040284). (ORPHA:457279)
- Contracture of the proximal interphalangeal joint of the 4th toe (HP:0100350): The proximal interphalangeal joint of the 4th toe cannot be straightened actively or passively. Evidence: TAS. Frequency: Very rare (HP:0040284). (ORPHA:457279)
These phenotypes are associated with the disease Intellectual disability-macrocephaly-hypotonia-behavioral abnormalities syndrome (ORPHA:457279).